- Poor speech (HP:0002465). Evidence: IEA. (OMIM:300062)
- Moderate intellectual disability (HP:0002342): Moderate intellectual disability (ID) is defined as a type of ID characterized by moderately sub-average adaptive functioning and intellectual functioning, with an intelligence quotient (IQ) the range of 35-49. Evidence: IEA. (OMIM:300062)
- Seizure (HP:0001250): A seizure is an intermittent abnormality of nervous system physiology characterized by a transient occurrence of signs and/or symptoms due to abnormal excessive or synchronous neuronal activity in the brain. Evidence: IEA. (OMIM:300062)
- Macroorchidism (HP:0000053): The presence of abnormally large testes. Evidence: IEA. (OMIM:300062)
- Abnormal facial shape (HP:0001999): An abnormal morphology (form) of the face or its components. Evidence: IEA. (OMIM:300062)
- X-linked inheritance (HP:0001417): A mode of inheritance that is observed for traits related to a gene encoded on the X chromosome. Evidence: IEA. (OMIM:300062)
These phenotypes are associated with the disease intellectual disability, X-linked 14 (OMIM:300062).